Phenotypes associated with the disease gallbladder disease 4 (OMIM:611465):
- Cholelithiasis (HP:0001081): Hard, pebble-like deposits that form within the gallbladder. Evidence: PCS. (PMID:17632509)
- Polygenic inheritance (HP:0010982): A mode of inheritance that depends on a mixture of major and minor genetic determinants possibly together with environmental factors. Diseases inherited in this manner are termed complex diseases. Evidence: PCS. (PMID:17632509)